Phenotypes associated with the disease cerebellar ataxia, benign, with thermoanalgesia (OMIM:212890):
- Late onset (HP:0003584): A type of adult onset with onset of symptoms after the age of 60 years. Evidence: TAS. (OMIM:212890)
- Impaired temperature sensation (HP:0010829): A reduced ability to discriminate between different temperatures. Evidence: TAS. Onset: Late onset (HP:0003584). (OMIM:212890)
- Autosomal recessive inheritance (HP:0000007): A mode of inheritance that is observed for traits related to a gene encoded on one of the autosomes (i.e., the human chromosomes 1-22) in which a trait manifests in individuals with two pathogenic alleles, either homozygotes (two copies of the same mutant allele) or compound heterozygotes (whereby each copy of a gene has a distinct mutant allele). Evidence: IEA. (OMIM:212890)
- Progressive cerebellar ataxia (HP:0002073). Evidence: IEA. Onset: Late onset (HP:0003584). (OMIM:212890)
- Axonal loss (HP:0003447): A reduction in the number of axons in the peripheral nervous system. Evidence: TAS. (OMIM:212890)